- Congenital hip dislocation (HP:0001374). Evidence: PCS. (PMID:36067312)
- Hypoplastic acetabulae (HP:0003274): Underdeveloped acetabulae. Evidence: PCS. (PMID:36067312)
- Infantile onset (HP:0003593): Onset of signs or symptoms of disease between 28 days to one year of life. Evidence: PCS. (PMID:36067312)
- Autosomal dominant inheritance (HP:0000006): A mode of inheritance that is observed for traits related to a gene encoded on one of the autosomes (i.e., the human chromosomes 1-22) in which a trait manifests in heterozygotes. In the context of medical genetics, an autosomal dominant disorder is caused when a single copy of the mutant allele is present. Males and females are affected equally, and can both transmit the disorder with a risk of 50% for each child of inheriting the mutant allele. Evidence: PCS. (PMID:36067312)
These phenotypes are associated with the disease developmental dysplasia of the hip 3 (OMIM:620690).